Phenotypes associated with the disease orofaciodigital syndrome VIII (OMIM:300484):
- Milia (HP:0001056): Presence of multiple small cysts containing keratin (skin protein) and presenting as tiny pearly-white bumps just under the surface of the skin. Evidence: TAS. (OMIM:300484)
- Cleft palate (HP:0000175): Cleft palate is a developmental defect of the palate resulting from a failure of fusion of the palatine processes and manifesting as a separation of the roof of the mouth (soft and hard palate). Evidence: TAS. (OMIM:300484)
- Strabismus (HP:0000486): A misalignment of the eyes so that the visual axes deviate from bifoveal fixation. The classification of strabismus may be based on a number of features including the relative position of the eyes, whether the deviation is latent or manifest, intermittent or constant, concomitant or otherwise and according to the age of onset and the relevance of any associated refractive error. Evidence: TAS. (OMIM:300484)
- Recurrent aspiration pneumonia (HP:0002100): Increased susceptibility to aspiration pneumonia, defined as pneumonia due to breathing in foreign material, as manifested by a medical history of repeated episodes of aspiration pneumonia. Evidence: TAS. (OMIM:300484)
- Short stature (HP:0004322): A height below that which is expected according to age and gender norms. Although there is no universally accepted definition of short stature, many refer to "short stature" as height more than 2 standard deviations below the mean for age and gender (or below the 3rd percentile for age and gender dependent norms). Evidence: TAS. (OMIM:300484)
- Median cleft upper lip (HP:0000161): A type of cleft lip presenting as a midline (median) gap in the upper lip. Evidence: TAS. (OMIM:300484)
- Global developmental delay (HP:0001263): A delay in the achievement of motor or mental milestones in the domains of development of a child, including motor skills, speech and language, cognitive skills, and social and emotional skills. This term should only be used to describe children younger than five years of age. Evidence: TAS. (OMIM:300484)
- Hamartoma (HP:0010566): A disordered proliferation of mature tissues that is native to the site of origin, e.g., exostoses, nevi and soft tissue hamartomas. Although most hamartomas are benign, some histologic subtypes, e.g., neuromuscular hamartoma, may proliferate aggressively such as mesenchymal cystic hamartoma, Sclerosing epithelial hamartoma, Sclerosing metanephric hamartoma. Evidence: IEA. (OMIM:300484)
- Polydactyly (HP:0010442): A congenital anomaly characterized by the presence of supernumerary fingers or toes. Evidence: TAS. (OMIM:300484)
- Telecanthus (HP:0000506): Distance between the inner canthi more than two standard deviations above the mean (objective); or, apparently increased distance between the inner canthi. Evidence: TAS. (OMIM:300484)
- X-linked recessive inheritance (HP:0001419): A mode of inheritance that is observed for recessive traits related to a gene encoded on the X chromosome. In the context of medical genetics, X-linked recessive disorders manifest in males (who have one copy of the X chromosome and are thus hemizygotes), but generally not in female heterozygotes who have one mutant and one normal allele. Evidence: TAS. (OMIM:300484)
- Hypertelorism (HP:0000316): Interpupillary distance more than 2 SD above the mean (alternatively, the appearance of an increased interpupillary distance or widely spaced eyes). Evidence: TAS. (OMIM:300484)
- High palate (HP:0000218): Height of the palate more than 2 SD above the mean (objective) or palatal height at the level of the first permanent molar more than twice the height of the teeth (subjective). Evidence: TAS. (OMIM:300484)
- Broad nasal tip (HP:0000455): Increase in width of the nasal tip. Evidence: TAS. (OMIM:300484)
- Syndactyly (HP:0001159): Webbing or fusion of the fingers or toes, involving soft parts only or including bone structure. Bony fusions are referred to as "bony" syndactyly if the fusion occurs in a radio-ulnar axis. Fusions of bones of the fingers or toes in a proximo-distal axis are referred to as "symphalangism". Evidence: TAS. (OMIM:300484)
- Short tibia (HP:0005736): Underdevelopment (reduced size) of the tibia. Evidence: TAS. (OMIM:300484)
- Bifid nasal tip (HP:0000456): A splitting of the nasal tip. Visually assessable vertical indentation, cleft, or depression of the nasal tip. Evidence: TAS. (OMIM:300484)
- Hypoplasia of the epiglottis (HP:0005349): Hypoplasia of the epiglottis. Evidence: TAS. (OMIM:300484)